Phenotypes associated with the disease Brown syndrome (OMIM:616407):
- Diplopia (HP:0000651): Diplopia is a condition in which a single object is perceived as two images, it is also known as double vision. Evidence: TAS. (PMID:1757853)
- Brown anomaly (HP:0031622): An ocular motility defect where the affected eye(s) does not elevate in adduction but has full depression in adduction. It can be congenital or acquired from injury to or defect of the superior oblique tendon or trochlea and has a positive forced duction test result. Evidence: TAS. (PMID:1757853)
- Autosomal dominant inheritance (HP:0000006): A mode of inheritance that is observed for traits related to a gene encoded on one of the autosomes (i.e., the human chromosomes 1-22) in which a trait manifests in heterozygotes. In the context of medical genetics, an autosomal dominant disorder is caused when a single copy of the mutant allele is present. Males and females are affected equally, and can both transmit the disorder with a risk of 50% for each child of inheriting the mutant allele. Evidence: PCS. (PMID:1757853)